- Wide mouth (HP:0000154): Distance between the oral commissures more than 2 SD above the mean. Alternatively, an apparently increased width of the oral aperture (subjective). Evidence: TAS. Frequency: Occasional (HP:0040283). (ORPHA:83619)
- Hypertelorism (HP:0000316): Interpupillary distance more than 2 SD above the mean (alternatively, the appearance of an increased interpupillary distance or widely spaced eyes). Evidence: TAS. Frequency: Occasional (HP:0040283). (ORPHA:83619)
- Preauricular skin tag (HP:0000384): A rudimentary tag of skin often containing ear tissue including a core of cartilage and located just anterior to the auricle (outer part of the ear). Evidence: TAS. Frequency: Frequent (HP:0040282). (ORPHA:83619)
- Ptosis (HP:0000508): The upper eyelid margin is positioned 3 mm or more lower than usual and covers the superior portion of the iris (objective); or, the upper lid margin obscures at least part of the pupil (subjective). Evidence: TAS. Frequency: Frequent (HP:0040282). (ORPHA:83619)
- Ophthalmoplegia (HP:0000602): Paralysis of one or more extraocular muscles that are responsible for eye movements. Evidence: TAS. Frequency: Frequent (HP:0040282). (ORPHA:83619)
- Preauricular pit (HP:0004467): Small indentation anterior to the insertion of the ear. Evidence: TAS. Frequency: Frequent (HP:0040282). (ORPHA:83619)
- Underdeveloped tragus (HP:0011272): Decreased posterolateral protrusion of the tragus. Evidence: TAS. Frequency: Occasional (HP:0040283). (ORPHA:83619)
- Abnormality of mouth shape (HP:0011338): An abnormality of the outline, configuration, or contour of the mouth. Evidence: TAS. Frequency: Frequent (HP:0040282). (ORPHA:83619)
These phenotypes are associated with the disease Macrostomia-preauricular tags-external ophthalmoplegia syndrome (ORPHA:83619).